- Abnormality of the nervous system (HP:0000707): An abnormality of the nervous system. Evidence: IEA. (OMIM:105570)
- Autosomal dominant inheritance (HP:0000006): A mode of inheritance that is observed for traits related to a gene encoded on one of the autosomes (i.e., the human chromosomes 1-22) in which a trait manifests in heterozygotes. In the context of medical genetics, an autosomal dominant disorder is caused when a single copy of the mutant allele is present. Males and females are affected equally, and can both transmit the disorder with a risk of 50% for each child of inheriting the mutant allele. Evidence: IEA. (OMIM:105570)
These phenotypes are associated with the disease ANDROSTENONE, ABILITY TO SMELL (OMIM:105570).